- Abnormality of taste sensation (HP:0000223). Evidence: IEA. (OMIM:108320)
This phenotype is associated with the disease ARTICHOKE, MODIFICATION OF TASTE BY (OMIM:108320).